Phenotypes associated with the disease Mucolipidosis type III alpha/beta (ORPHA:423461):
- Joint stiffness (HP:0001387): Joint stiffness is a perceived sensation of tightness in a joint or joints when attempting to move them after a period of inactivity. Joint stiffness typically subsides over time. Evidence: TAS. Frequency: Very frequent (HP:0040281). (ORPHA:423461)
- Short stature (HP:0004322): A height below that which is expected according to age and gender norms. Although there is no universally accepted definition of short stature, many refer to "short stature" as height more than 2 standard deviations below the mean for age and gender (or below the 3rd percentile for age and gender dependent norms). Evidence: TAS. Frequency: Very frequent (HP:0040281). (ORPHA:423461)
- Postnatal growth retardation (HP:0008897): Slow or limited growth after birth. Evidence: TAS. Frequency: Very frequent (HP:0040281). (ORPHA:423461)
- Oligosacchariduria (HP:0010471): Increased urinary excretion of oligosaccharides (low molecular weight carbohydrate chains composed of at least three monosaccharide subunits), derived from a partial degradation of glycoproteins. Evidence: TAS. Frequency: Very frequent (HP:0040281). (ORPHA:423461)
- Gingival overgrowth (HP:0000212): Hyperplasia of the gingiva (that is, a thickening of the soft tissue overlying the alveolar ridge. The degree of thickening ranges from involvement of the interdental papillae alone to gingival overgrowth covering the entire tooth crown. Evidence: TAS. Frequency: Frequent (HP:0040282). (ORPHA:423461)
- Coarse facial features (HP:0000280): Absence of fine and sharp appearance of brows, nose, lips, mouth, and chin, usually because of rounded and heavy features or thickened skin with or without thickening of subcutaneous and bony tissues. Evidence: TAS. Frequency: Frequent (HP:0040282). (ORPHA:423461)
- Epicanthus (HP:0000286): A fold of skin starting above the medial aspect of the upper eyelid and arching downward to cover, pass in front of and lateral to the medial canthus. Evidence: TAS. Frequency: Frequent (HP:0040282). (ORPHA:423461)
- Full cheeks (HP:0000293): Increased prominence or roundness of soft tissues between zygomata and mandible. Evidence: TAS. Frequency: Frequent (HP:0040282). (ORPHA:423461)
- Recurrent otitis media (HP:0000403): Increased susceptibility to otitis media, as manifested by recurrent episodes of otitis media. Evidence: TAS. Frequency: Frequent (HP:0040282). (ORPHA:423461)
- Conductive hearing impairment (HP:0000405): An abnormality of vibrational conductance of sound to the inner ear leading to impairment of sensory perception of sound. Evidence: TAS. Frequency: Frequent (HP:0040282). (ORPHA:423461)
- Short neck (HP:0000470): Diminished length of the neck. Evidence: TAS. Frequency: Frequent (HP:0040282). (ORPHA:423461)
- Dysostosis multiplex (HP:0000943). Evidence: TAS. Frequency: Frequent (HP:0040282). (ORPHA:423461)
- Thickened skin (HP:0001072): Laminar thickening of skin. Evidence: TAS. Frequency: Frequent (HP:0040282). (ORPHA:423461)
- Gait disturbance (HP:0001288): The term gait disturbance can refer to any disruption of the ability to walk. Evidence: TAS. Frequency: Frequent (HP:0040282). (ORPHA:423461)
- Flexion contracture (HP:0001371): A flexion contracture is a bent (flexed) joint that cannot be straightened actively or passively. It is thus a chronic loss of joint motion due to structural changes in muscle, tendons, ligaments, or skin that prevents normal movement of joints. Evidence: TAS. Frequency: Frequent (HP:0040282). (ORPHA:423461)
- Mitral regurgitation (HP:0001653): An abnormality of the mitral valve characterized by insufficiency or incompetence of the mitral valve resulting in retrograde leaking of blood through the mitral valve upon ventricular contraction. Evidence: TAS. Frequency: Frequent (HP:0040282). (ORPHA:423461)
- Aortic regurgitation (HP:0001659): An insufficiency of the aortic valve, leading to regurgitation (backward flow) of blood from the aorta into the left ventricle. Evidence: TAS. Frequency: Frequent (HP:0040282). (ORPHA:423461)
- Bone pain (HP:0002653): An unpleasant sensation characterized by physical discomfort (such as pricking, throbbing, or aching) localized to bone. Evidence: TAS. Frequency: Frequent (HP:0040282). (ORPHA:423461)
- Kyphoscoliosis (HP:0002751): An abnormal curvature of the spine in both a coronal (lateral) and sagittal (back-to-front) plane. Evidence: TAS. Frequency: Frequent (HP:0040282). (ORPHA:423461)
- Depressed nasal bridge (HP:0005280): Posterior positioning of the nasal root in relation to the overall facial profile for age. Evidence: TAS. Frequency: Frequent (HP:0040282). (ORPHA:423461)
- Abdominal wall muscle weakness (HP:0009023): Decreased strength of the abdominal musculature. Evidence: TAS. Frequency: Frequent (HP:0040282). (ORPHA:423461)
- Keratan sulfate excretion in urine (HP:0012069): An increased concentration of keratan sulfate in the urine. Evidence: TAS. Frequency: Frequent (HP:0040282). (ORPHA:423461)
- Generalized osteoporosis (HP:0040160). Evidence: TAS. Frequency: Frequent (HP:0040282). (ORPHA:423461)
- Umbilical hernia (HP:0001537): Protrusion of abdominal contents through a defect in the abdominal wall musculature around the umbilicus. Skin and subcutaneous tissue overlie the defect. Evidence: TAS. Frequency: Occasional (HP:0040283). (ORPHA:423461)
- Diastasis recti (HP:0001540): A separation of the rectus abdominis muscle into right and left halves (which are normally joined at the midline at the linea alba). Evidence: TAS. Frequency: Occasional (HP:0040283). (ORPHA:423461)
- Hoarse voice (HP:0001609): Hoarseness refers to a change in the pitch or quality of the voice, with the voice sounding weak, very breathy, scratchy, or husky. Evidence: TAS. Frequency: Occasional (HP:0040283). (ORPHA:423461)
- Congestive heart failure (HP:0001635): The presence of an abnormality of cardiac function that is responsible for the failure of the heart to pump blood at a rate that is commensurate with the needs of the tissues or a state in which abnormally elevated filling pressures are required for the heart to do so. Heart failure is frequently related to a defect in myocardial contraction. Evidence: TAS. Frequency: Occasional (HP:0040283). (ORPHA:423461)
- Right ventricular hypertrophy (HP:0001667): In this case the right ventricle is more muscular than normal, causing a characteristic boot-shaped (coeur-en-sabot) appearance as seen on anterior- posterior chest x-rays. Right ventricular hypertrophy is commonly associated with any form of right ventricular outflow obstruction or pulmonary hypertension, which may in turn owe its origin to left-sided disease. The echocardiographic signs are thickening of the anterior right ventricular wall and the septum. Cavity size is usually normal, or slightly enlarged. In many cases there is associated volume overload present due to tricuspid regurgitation, in the absence of this, septal motion is normal. Evidence: TAS. Frequency: Occasional (HP:0040283). (ORPHA:423461)
- Loss of ambulation (HP:0002505): Inability to walk in a person who previous had the ability to walk. Evidence: TAS. Frequency: Occasional (HP:0040283). (ORPHA:423461)
- Recurrent upper respiratory tract infections (HP:0002788): An increased susceptibility to upper respiratory tract infections as manifested by a history of recurrent upper respiratory tract infections (running ears - otitis, sinusitis, pharyngitis, tonsillitis). Evidence: TAS. Frequency: Occasional (HP:0040283). (ORPHA:423461)
- Osteolysis (HP:0002797): Osteolysis refers to the destruction of bone through bone resorption with removal or loss of calcium. Evidence: TAS. Frequency: Occasional (HP:0040283). (ORPHA:423461)
- Corneal opacity (HP:0007957): A reduction of corneal clarity. Evidence: TAS. Frequency: Occasional (HP:0040283). (ORPHA:423461)
- Constrictive median neuropathy (HP:0012185): Injury to the median nerve caused by its entrapment at the wrist as it traverses through the carpal tunnel. Clinically, constrictive median neuropathy is characterized by pain, paresthesia, and weakness in the median nerve distribution of the hand. Evidence: TAS. Frequency: Occasional (HP:0040283). (ORPHA:423461)
- Cognitive impairment (HP:0100543): Abnormal cognition is characterized by deficits in thinking, reasoning, or remembering. Evidence: TAS. Frequency: Occasional (HP:0040283). (ORPHA:423461)
- Sensorineural hearing impairment (HP:0000407): A type of hearing impairment in one or both ears related to an abnormal functionality of the cochlear nerve. Evidence: TAS. Frequency: Very rare (HP:0040284). (ORPHA:423461)
- Proptosis (HP:0000520): An eye that is protruding anterior to the plane of the face to a greater extent than is typical. Evidence: TAS. Frequency: Very rare (HP:0040284). (ORPHA:423461)